- Shallow anterior chamber (HP:0000594): Reduced depth of the anterior chamber, i.e., the anteroposterior distance between the cornea and the iris is decreased. Evidence: PCS. Frequency: 6/7. (PMID:19836009)
- Brachydactyly (HP:0001156): Digits that appear disproportionately short compared to the hand/foot. The word brachydactyly is used here to describe a series distinct patterns of shortened digits (brachydactyly types A-E). This is the sense used here. Evidence: PCS. Frequency: 0/7. (PMID:19836009)
- Short stature (HP:0004322): A height below that which is expected according to age and gender norms. Although there is no universally accepted definition of short stature, many refer to "short stature" as height more than 2 standard deviations below the mean for age and gender (or below the 3rd percentile for age and gender dependent norms). Evidence: PCS. Frequency: 5/7. (PMID:19836009)
- Joint stiffness (HP:0001387): Joint stiffness is a perceived sensation of tightness in a joint or joints when attempting to move them after a period of inactivity. Joint stiffness typically subsides over time. Evidence: PCS. Frequency: 0/7. (PMID:19836009)
- Ocular hypertension (HP:0007906): Intraocular pressure that is 2 standard deviations above the population mean. Evidence: PCS. Frequency: 4/6. (PMID:19836009)
- Phakodonesis (HP:0012629): Tremulousness (trembling) of the lens of the eye. Evidence: IEA. (OMIM:613195)
- Posterior synechiae of the anterior chamber (HP:0011484): Adhesions between the iris and the lens. Evidence: PCS. Frequency: 5/7. (PMID:19836009)
- Autosomal recessive inheritance (HP:0000007): A mode of inheritance that is observed for traits related to a gene encoded on one of the autosomes (i.e., the human chromosomes 1-22) in which a trait manifests in individuals with two pathogenic alleles, either homozygotes (two copies of the same mutant allele) or compound heterozygotes (whereby each copy of a gene has a distinct mutant allele). Evidence: PCS. (PMID:19836009)
- Ectopia lentis (HP:0001083): Dislocation or malposition of the crystalline lens of the eye. A partial displacement (or dislocation) of the lens is described as a subluxation of the lens, while a complete displacement is termed luxation of the lens. A complete displacement occurs if the lens is completely outside the patellar fossa of the lens, either in the anterior chamber, in the vitreous, or directly on the retina. If the lens is partially displaced but still contained within the lens space, then it is termed subluxation. Evidence: PCS. (PMID:19836009)
- High myopia (HP:0011003): A severe form of myopia with greater than -6.00 diopters. Evidence: PCS. Frequency: 7/7. (PMID:19836009)
- Glaucoma (HP:0000501): Glaucoma refers loss of retinal ganglion cells in a characteristic pattern of optic neuropathy usually associated with increased intraocular pressure. Evidence: PCS. Frequency: 4/7. (PMID:19836009)
- Iridodonesis (HP:0100693): Tremulousness of the iris on movement of the eye, occurring in subluxation of the lens. Evidence: IEA. (OMIM:613195)
These phenotypes are associated with the disease Weill-Marchesani 4 syndrome, recessive (OMIM:613195).